- Hypospadias (HP:0000047): Abnormal position of urethral meatus on the ventral penile shaft (underside) characterized by displacement of the urethral meatus from the tip of the glans penis to the ventral surface of the penis, scrotum, or perineum. Evidence: TAS. Frequency: Frequent (HP:0040282). (ORPHA:1913)
- Ambiguous genitalia (HP:0000062): A genital phenotype that is not clearly assignable to a single gender. Ambiguous genitalia can be evaluated using the Prader scale: Prader 0: Normal female external genitalia. Prader 1: Female external genitalia with clitoromegaly. Prader 2: Clitoromegaly with partial labial fusion forming a funnel-shaped urogenital sinus. Prader 3: Increased phallic enlargement. Complete labioscrotal fusion forming a urogenital sinus with a single opening. Prader 4: Complete scrotal fusion with urogenital opening at the base or on the shaft of the phallus. Prader 5: Normal male external genitalia. The diagnosis of ambiguous genitalia is made for Prader 1-4. Evidence: TAS. Frequency: Frequent (HP:0040282). (ORPHA:1913)
- High palate (HP:0000218): Height of the palate more than 2 SD above the mean (objective) or palatal height at the level of the first permanent molar more than twice the height of the teeth (subjective). Evidence: TAS. Frequency: Frequent (HP:0040282). (ORPHA:1913)
- Brachycephaly (HP:0000248): An abnormality of skull shape characterized by a decreased anterior-posterior diameter. That is, a cephalic index greater than 81%. Alternatively, an apparently shortened anteroposterior dimension (length) of the head compared to width. Evidence: TAS. Frequency: Very frequent (HP:0040281). (ORPHA:1913)
- Microcephaly (HP:0000252): Head circumference below 2 standard deviations below the mean for age and gender. Evidence: TAS. Frequency: Frequent (HP:0040282). (ORPHA:1913)
- Epicanthus (HP:0000286): A fold of skin starting above the medial aspect of the upper eyelid and arching downward to cover, pass in front of and lateral to the medial canthus. Evidence: TAS. Frequency: Very frequent (HP:0040281). (ORPHA:1913)
- Micrognathia (HP:0000347): Developmental hypoplasia of the mandible. Evidence: TAS. Frequency: Very frequent (HP:0040281). (ORPHA:1913)
- Low-set ears (HP:0000369): Upper insertion of the ear to the scalp below an imaginary horizontal line drawn between the inner canthi of the eye and extending posteriorly to the ear. Evidence: TAS. Frequency: Very frequent (HP:0040281). (ORPHA:1913)
- Overfolded helix (HP:0000396): A condition in which the helix is folded over to a greater degree than normal. That is, excessive curling of the helix edge, whereby the free edge is parallel to the plane of the ear. Evidence: TAS. Frequency: Very frequent (HP:0040281). (ORPHA:1913)
- Strabismus (HP:0000486): A misalignment of the eyes so that the visual axes deviate from bifoveal fixation. The classification of strabismus may be based on a number of features including the relative position of the eyes, whether the deviation is latent or manifest, intermittent or constant, concomitant or otherwise and according to the age of onset and the relevance of any associated refractive error. Evidence: TAS. Frequency: Frequent (HP:0040282). (ORPHA:1913)
- Ptosis (HP:0000508): The upper eyelid margin is positioned 3 mm or more lower than usual and covers the superior portion of the iris (objective); or, the upper lid margin obscures at least part of the pupil (subjective). Evidence: TAS. Frequency: Frequent (HP:0040282). (ORPHA:1913)
- Synophrys (HP:0000664): Meeting of the medial eyebrows in the midline. Evidence: TAS. Frequency: Very frequent (HP:0040281). (ORPHA:1913)
- Intellectual disability (HP:0001249): The term intellectual disability or intellectual developmental disorder is used to describe significantly sub-average intellectual and adaptive functioning based on clinical assessment and as measured by individually administered, appropriately normed, standardized and validated tests of intellectual functioning and adaptive behavior, with onset during the developmental period from infancy through adolescence. Evidence: TAS. Frequency: Very frequent (HP:0040281). (ORPHA:1913)
- Global developmental delay (HP:0001263): A delay in the achievement of motor or mental milestones in the domains of development of a child, including motor skills, speech and language, cognitive skills, and social and emotional skills. This term should only be used to describe children younger than five years of age. Evidence: TAS. Frequency: Very frequent (HP:0040281). (ORPHA:1913)
- Intrauterine growth retardation (HP:0001511): An abnormal restriction of fetal growth with fetal weight below the tenth percentile for gestational age. Evidence: TAS. Frequency: Very frequent (HP:0040281). (ORPHA:1913)
- Ventricular septal defect (HP:0001629): A hole between the two bottom chambers (ventricles) of the heart. The defect is centered around the most superior aspect of the ventricular septum. Evidence: TAS. Frequency: Frequent (HP:0040282). (ORPHA:1913)
- Atrial septal defect (HP:0001631): Atrial septal defect (ASD) is a congenital abnormality of the interatrial septum that enables blood flow between the left and right atria via the interatrial septum. Evidence: TAS. Frequency: Frequent (HP:0040282). (ORPHA:1913)
- Tetralogy of Fallot (HP:0001636): A congenital cardiac malformation comprising pulmonary stenosis, overriding aorta, ventricular septum defect, and right ventricular hypertrophy. The diagnosis of TOF is made if at least three of the four above mentioned features are present. Evidence: TAS. Frequency: Frequent (HP:0040282). (ORPHA:1913)
- Transposition of the great arteries (HP:0001669): A complex congenital heart defect in which the aorta arises from the morphologic right ventricle and the pulmonary artery arises from the morphologic left ventricle. Evidence: TAS. Frequency: Occasional (HP:0040283). (ORPHA:1913)
- Scoliosis (HP:0002650): The presence of an abnormal lateral curvature of the spine. Evidence: TAS. Frequency: Occasional (HP:0040283). (ORPHA:1913)
- Short nose (HP:0003196): Distance from nasion to subnasale more than two standard deviations below the mean, or alternatively, an apparently decreased length from the nasal root to the nasal tip. Evidence: TAS. Frequency: Very frequent (HP:0040281). (ORPHA:1913)
- Depressed nasal bridge (HP:0005280): Posterior positioning of the nasal root in relation to the overall facial profile for age. Evidence: TAS. Frequency: Very frequent (HP:0040281). (ORPHA:1913)
- Bilateral single transverse palmar creases (HP:0007598): The distal and proximal transverse palmar creases are merged into a single transverse palmar crease on both hands. Evidence: TAS. Frequency: Frequent (HP:0040282). (ORPHA:1913)
- Abnormal helix morphology (HP:0011039): An abnormality of the helix. The helix is the outer rim of the ear that extends from the insertion of the ear on the scalp (root) to the termination of the cartilage at the earlobe. Evidence: TAS. Frequency: Very frequent (HP:0040281). (ORPHA:1913)
- Prominent forehead (HP:0011220): Forward prominence of the entire forehead, due to protrusion of the frontal bone. Evidence: TAS. Frequency: Very frequent (HP:0040281). (ORPHA:1913)
- Midface retrusion (HP:0011800): Posterior positions and/or vertical shortening of the infraorbital and perialar regions, or increased concavity of the face and/or reduced nasolabial angle. Evidence: TAS. Frequency: Very frequent (HP:0040281). (ORPHA:1913)
These phenotypes are associated with the disease Fetal trimethadione syndrome (ORPHA:1913).